- Pleural effusion (HP:0002202): The presence of an excessive amount of fluid in the pleural cavity. Evidence: PCS. Frequency: 1/2. (PMID:39198650)
- Thymus hyperplasia (HP:0010516): Enlargement of the thymus. Evidence: PCS. Frequency: 1/2. (PMID:39198650)
- Pulmonary tuberculosis (HP:0032262): A lung infection by Mycobacterium tuberculosis a slightly curved non-motile, aerobic, non-capsulated and non-spore forming strains of mycobacteria. Evidence: PCS. Frequency: 2/2. (PMID:39198650)
- Shock (HP:0031273): The state in which profound and widespread reduction of effective tissue perfusion leads first to reversible, and then if prolonged, to irreversible cellular injury. Evidence: PCS. Frequency: 1/2. (PMID:39198650)
- Young adult onset (HP:0011462): Onset of disease at the age of between 16 and 40 years. Evidence: PCS. Frequency: 2/2. (PMID:39198650)
- Autosomal recessive inheritance (HP:0000007): A mode of inheritance that is observed for traits related to a gene encoded on one of the autosomes (i.e., the human chromosomes 1-22) in which a trait manifests in individuals with two pathogenic alleles, either homozygotes (two copies of the same mutant allele) or compound heterozygotes (whereby each copy of a gene has a distinct mutant allele). Evidence: PCS. (PMID:39198650)
These phenotypes are associated with the disease immunodeficiency 127 (OMIM:620977).